Phenotypes associated with the disease Cleft lip/palate-ectodermal dysplasia syndrome (ORPHA:3253):
- Small scrotum (HP:0000046): Apparently small scrotum for age. Evidence: TAS. Frequency: Frequent (HP:0040282). (ORPHA:3253)
- Abnormality of the ureter (HP:0000069): An abnormality of the ureter. The ureter is the duct by which urine passes from the kidney to the bladder. Evidence: TAS. Frequency: Occasional (HP:0040283). (ORPHA:3253)
- Hypogonadism (HP:0000135): A decreased functionality of the gonad. Evidence: TAS. Frequency: Frequent (HP:0040282). (ORPHA:3253)
- Abnormality of the dentition (HP:0000164): Any abnormality of the teeth. Evidence: TAS. Frequency: Frequent (HP:0040282). (ORPHA:3253)
- Cleft upper lip (HP:0000204): A gap or groove in the upper lip. This is a congenital defect resulting from nonfusion of tissues of the lip during embryonal development. Evidence: TAS. Frequency: Very frequent (HP:0040281). (ORPHA:3253)
- Micrognathia (HP:0000347): Developmental hypoplasia of the mandible. Evidence: TAS. Frequency: Frequent (HP:0040282). (ORPHA:3253)
- Macrotia (HP:0000400): Median longitudinal ear length greater than two standard deviations above the mean and median ear width greater than two standard deviations above the mean (objective); or, apparent increase in length and width of the pinna (subjective). Evidence: TAS. Frequency: Very frequent (HP:0040281). (ORPHA:3253)
- Protruding ear (HP:0000411): Angle formed by the plane of the ear and the mastoid bone greater than the 97th centile for age (objective); or, outer edge of the helix more than 2 cm from the mastoid at the point of maximum distance (objective). Evidence: TAS. Frequency: Frequent (HP:0040282). (ORPHA:3253)
- Wide nasal bridge (HP:0000431): Increased breadth of the nasal bridge (and with it, the nasal root). Evidence: TAS. Frequency: Frequent (HP:0040282). (ORPHA:3253)
- Downslanted palpebral fissures (HP:0000494): The palpebral fissure inclination is more than two standard deviations below the mean. Evidence: TAS. Frequency: Frequent (HP:0040282). (ORPHA:3253)
- Synophrys (HP:0000664): Meeting of the medial eyebrows in the midline. Evidence: TAS. Frequency: Frequent (HP:0040282). (ORPHA:3253)
- Hypodontia (HP:0000668): The absence of five or less teeth from the normal series by a failure to develop. Evidence: TAS. Frequency: Occasional (HP:0040283). (ORPHA:3253)
- Carious teeth (HP:0000670): Caries is a multifactorial bacterial infection affecting the structure of the tooth. This term has been used to describe the presence of more than expected dental caries. Evidence: TAS. Frequency: Frequent (HP:0040282). (ORPHA:3253)
- Anodontia (HP:0000674): The absence of all teeth from the normal series by a failure to develop. Evidence: TAS. Frequency: Occasional (HP:0040283). (ORPHA:3253)
- Abnormal dental enamel morphology (HP:0000682): An abnormality of the dental enamel. Evidence: TAS. Frequency: Occasional (HP:0040283). (ORPHA:3253)
- Hypohidrosis (HP:0000966): Abnormally diminished capacity to sweat. Evidence: TAS. Frequency: Occasional (HP:0040283). (ORPHA:3253)
- Ectodermal dysplasia (HP:0000968): Ectodermal dysplasia is a group of conditions in which there is abnormal development of the skin, hair, nails, teeth, or sweat glands. Evidence: TAS. Frequency: Very frequent (HP:0040281). (ORPHA:3253)
- Palmoplantar hyperkeratosis (HP:0000972): Abnormal thickening of the skin localized to the palm of the hand and the sole of the foot. Evidence: TAS. Frequency: Occasional (HP:0040283). (ORPHA:3253)
- Intellectual disability (HP:0001249): The term intellectual disability or intellectual developmental disorder is used to describe significantly sub-average intellectual and adaptive functioning based on clinical assessment and as measured by individually administered, appropriately normed, standardized and validated tests of intellectual functioning and adaptive behavior, with onset during the developmental period from infancy through adolescence. Evidence: TAS. Frequency: Frequent (HP:0040282). (ORPHA:3253)
- Seizure (HP:0001250): A seizure is an intermittent abnormality of nervous system physiology characterized by a transient occurrence of signs and/or symptoms due to abnormal excessive or synchronous neuronal activity in the brain. Evidence: TAS. Frequency: Occasional (HP:0040283). (ORPHA:3253)
- Alopecia (HP:0001596): A noncongenital process of hair loss, which may progress to partial or complete baldness. Evidence: TAS. Frequency: Frequent (HP:0040282). (ORPHA:3253)
- Toe syndactyly (HP:0001770): Webbing or fusion of the toes, involving soft parts only or including bone structure. Bony fusions are referred to as "bony" Syndactyly if the fusion occurs in a radio-ulnar axis. Fusions of bones of the toes in a proximo-distal axis are referred to as "Symphalangism". Evidence: TAS. Frequency: Very frequent (HP:0040281). (ORPHA:3253)
- Dystrophic toenail (HP:0001810): Toenail changes apart from changes of the color of the toenail (nail dyschromia) that involve partial or complete disruption of the various keratinous layers of the nail plate. Evidence: TAS. Frequency: Frequent (HP:0040282). (ORPHA:3253)
- Abnormal speech pattern (HP:0002167): An abnormality in the sound (volume) or cadence (rate) of speech. Evidence: TAS. Frequency: Frequent (HP:0040282). (ORPHA:3253)
- Recurrent respiratory infections (HP:0002205): An increased susceptibility to respiratory infections as manifested by a history of recurrent respiratory infections. Evidence: TAS. Frequency: Frequent (HP:0040282). (ORPHA:3253)
- EEG abnormality (HP:0002353): Abnormality observed by electroencephalogram (EEG), which is used to record of the brain's spontaneous electrical activity from multiple electrodes placed on the scalp. Evidence: TAS. Frequency: Occasional (HP:0040283). (ORPHA:3253)
- Highly arched eyebrow (HP:0002553): Increased height of the central portion of the eyebrow, forming a crescent, semicircular, or inverted U shape. Evidence: TAS. Frequency: Frequent (HP:0040282). (ORPHA:3253)
- Hyperlordosis (HP:0003307): Abnormally increased curvature (anterior concavity) of the lumbar or cervical spine. Evidence: TAS. Frequency: Occasional (HP:0040283). (ORPHA:3253)
- Pili torti (HP:0003777): Pili (from Latin pilus, hair) torti (from Latin tortus, twisted) refers to short and brittle hairs that appear flattened and twisted when viewed through a microscope. Evidence: TAS. Frequency: Frequent (HP:0040282). (ORPHA:3253)
- Sparse lateral eyebrow (HP:0005338): Decreased density/number and/or decreased diameter of lateral eyebrow hairs. Evidence: TAS. Frequency: Frequent (HP:0040282). (ORPHA:3253)
- Finger syndactyly (HP:0006101): Webbing or fusion of the fingers, involving soft parts only or including bone structure. Bony fusions are referred to as "bony" Syndactyly if the fusion occurs in a radio-ulnar axis. Fusions of bones of the fingers in a proximo-distal axis are referred to as "Symphalangism". Evidence: TAS. Frequency: Very frequent (HP:0040281). (ORPHA:3253)
- Abnormal dental morphology (HP:0006482): An abnormality of the morphology of the tooth. Evidence: TAS. Frequency: Frequent (HP:0040282). (ORPHA:3253)
- Wide intermamillary distance (HP:0006610): A larger than usual distance between the left and right nipple. Evidence: TAS. Frequency: Frequent (HP:0040282). (ORPHA:3253)
- Abnormal dermatoglyphics (HP:0007477): An abnormality of dermatoglyphs (fingerprints), which are present on fingers, palms, toes, and soles. Evidence: TAS. Frequency: Occasional (HP:0040283). (ORPHA:3253)
- Bilateral single transverse palmar creases (HP:0007598): The distal and proximal transverse palmar creases are merged into a single transverse palmar crease on both hands. Evidence: TAS. Frequency: Frequent (HP:0040282). (ORPHA:3253)
- Sparse hair (HP:0008070): Reduced density of hairs. Evidence: TAS. Frequency: Frequent (HP:0040282). (ORPHA:3253)
- Dystrophic fingernails (HP:0008391): The presence of misshapen or partially destroyed nail plates, often with accumulation of soft, yellow keratin between the dystrophic nail plate and nail bed, resulting in elevation of the nail plate. Evidence: TAS. Frequency: Frequent (HP:0040282). (ORPHA:3253)
- Nail dystrophy (HP:0008404): Onychodystrophy (nail dystrophy) refers to nail changes apart from changes of the color (nail dyschromia) and involves partial or complete disruption of the various keratinous layers of the nail plate. Evidence: TAS. Frequency: Frequent (HP:0040282). (ORPHA:3253)
- Hypoplasia of the zygomatic bone (HP:0010669): Underdevelopment of the zygomatic bone. That is, a reduction in size of the zygomatic bone, including the zygomatic process of the temporal bone of the skull, which forms part of the zygomatic arch. Evidence: TAS. Frequency: Frequent (HP:0040282). (ORPHA:3253)
- Midface retrusion (HP:0011800): Posterior positions and/or vertical shortening of the infraorbital and perialar regions, or increased concavity of the face and/or reduced nasolabial angle. Evidence: TAS. Frequency: Frequent (HP:0040282). (ORPHA:3253)
- Aplasia/Hypoplasia of the eyebrow (HP:0100840): Absence or underdevelopment of the eyebrow. Evidence: TAS. Frequency: Frequent (HP:0040282). (ORPHA:3253)